- Sensorineural hearing impairment (HP:0000407): A type of hearing impairment in one or both ears related to an abnormal functionality of the cochlear nerve. Evidence: TAS. Frequency: Frequent (HP:0040282). (ORPHA:2866)
- Glaucoma (HP:0000501): Glaucoma refers loss of retinal ganglion cells in a characteristic pattern of optic neuropathy usually associated with increased intraocular pressure. Evidence: TAS. Frequency: Frequent (HP:0040282). (ORPHA:2866)
- Craniosynostosis (HP:0001363): Craniosynostosis refers to the premature closure of the cranial sutures. Primary craniosynostosis refers to the closure of one or more sutures due to abnormalities in skull development, and secondary craniosynostosis results from failure of brain growth. Evidence: TAS. Frequency: Frequent (HP:0040282). (ORPHA:2866)
- Mutism (HP:0002300): Complete lack of speech or verbal communication in a person despite attempts to engage in conversation. Mutism as a phenomena assumes the individual has previous capacity for speech and in the pediatric population it assumes that the person is past the age of typical language development. Evidence: TAS. Frequency: Frequent (HP:0040282). (ORPHA:2866)
- Neoplasm (HP:0002664): An organ or organ-system abnormality that consists of uncontrolled autonomous cell-proliferation which can occur in any part of the body as a benign or malignant neoplasm (tumor). Evidence: TAS. Frequency: Occasional (HP:0040283). (ORPHA:2866)
- Short stature (HP:0004322): A height below that which is expected according to age and gender norms. Although there is no universally accepted definition of short stature, many refer to "short stature" as height more than 2 standard deviations below the mean for age and gender (or below the 3rd percentile for age and gender dependent norms). Evidence: TAS. Frequency: Frequent (HP:0040282). (ORPHA:2866)
- Ectopic anus (HP:0004397): Abnormal displacement or malposition of the anus. Evidence: TAS. Frequency: Frequent (HP:0040282). (ORPHA:2866)
- Abnormality of immune system physiology (HP:0010978): A functional abnormality of the immune system. Evidence: TAS. Frequency: Frequent (HP:0040282). (ORPHA:2866)
These phenotypes are associated with the disease Short stature-deafness-neutrophil dysfunction-dysmorphism syndrome (ORPHA:2866).